- Telangiectasia (HP:0001009): Telangiectasias refer to small dilated blood vessels located near the surface of the skin or mucous membranes, measuring between 0.5 and 1 millimeter in diameter. Telangiectasia are located especially on the tongue, lips, palate, fingers, face, conjunctiva, trunk, nail beds, and fingertips. Evidence: TAS. Frequency: Very frequent (HP:0040281). (ORPHA:2573)
- Intellectual disability (HP:0001249): The term intellectual disability or intellectual developmental disorder is used to describe significantly sub-average intellectual and adaptive functioning based on clinical assessment and as measured by individually administered, appropriately normed, standardized and validated tests of intellectual functioning and adaptive behavior, with onset during the developmental period from infancy through adolescence. Evidence: TAS. Frequency: Frequent (HP:0040282). (ORPHA:2573)
- Seizure (HP:0001250): A seizure is an intermittent abnormality of nervous system physiology characterized by a transient occurrence of signs and/or symptoms due to abnormal excessive or synchronous neuronal activity in the brain. Evidence: TAS. Frequency: Frequent (HP:0040282). (ORPHA:2573)
- Ventriculomegaly (HP:0002119): An increase in size of the ventricular system of the brain. Evidence: TAS. Frequency: Frequent (HP:0040282). (ORPHA:2573)
- Abnormal cerebral vascular morphology (HP:0100659): An anomaly of the cerebral blood vessels. Evidence: TAS. Frequency: Frequent (HP:0040282). (ORPHA:2573)
These phenotypes are associated with the disease Moyamoya disease (ORPHA:2573).